Phenotypes associated with the disease rhiny (OMIM:180360):
- Thin vermilion border (HP:0000233): Height of the vermilion of the medial part of the lip more than 2 SD below the mean, or apparently reduced height of the vermilion of the lip in the frontal view. The vermilion is the red part of the lips (and confusingly, the vermilion itself is also often referred to as being equivalent the lips). Evidence: TAS. (OMIM:180360)
- Inguinal hernia (HP:0000023): Protrusion of the contents of the abdominal cavity through the inguinal canal. Evidence: IEA. (OMIM:180360)
- Anteverted nares (HP:0000463): Anteriorly-facing nostrils viewed with the head in the Frankfurt horizontal and the eyes of the observer level with the eyes of the subject. This gives the appearance of an upturned nose (upturned nasal tip). Evidence: IEA. (OMIM:180360)
- Short nose (HP:0003196): Distance from nasion to subnasale more than two standard deviations below the mean, or alternatively, an apparently decreased length from the nasal root to the nasal tip. Evidence: TAS. (OMIM:180360)
- Autosomal dominant inheritance (HP:0000006): A mode of inheritance that is observed for traits related to a gene encoded on one of the autosomes (i.e., the human chromosomes 1-22) in which a trait manifests in heterozygotes. In the context of medical genetics, an autosomal dominant disorder is caused when a single copy of the mutant allele is present. Males and females are affected equally, and can both transmit the disorder with a risk of 50% for each child of inheriting the mutant allele. Evidence: IEA. (OMIM:180360)